- Inflammation of the large intestine (HP:0002037): Inflammation, or an inflammatory state in the large intestine. Evidence: IEA. (OMIM:612244)
This phenotype is associated with the disease inflammatory bowel disease 13 (OMIM:612244).